- Seizure (HP:0001250): A seizure is an intermittent abnormality of nervous system physiology characterized by a transient occurrence of signs and/or symptoms due to abnormal excessive or synchronous neuronal activity in the brain. Evidence: TAS. (OMIM:300491)
- X-linked recessive inheritance (HP:0001419): A mode of inheritance that is observed for recessive traits related to a gene encoded on the X chromosome. In the context of medical genetics, X-linked recessive disorders manifest in males (who have one copy of the X chromosome and are thus hemizygotes), but generally not in female heterozygotes who have one mutant and one normal allele. Evidence: TAS. (OMIM:300491)
- Aggressive behavior (HP:0000718): Behavior or an act aimed at harming a person, animal, or physical property (e.g., acts of physical violence; shouting, swearing, and using harsh language; slashing someone's tires). Evidence: TAS. (OMIM:300491)
- Autistic behavior (HP:0000729): Persistent deficits in social interaction and communication and interaction as well as a markedly restricted repertoire of activity and interest as well as repetitive patterns of behavior. Evidence: TAS. (OMIM:300491)
- Specific learning disability (HP:0001328): Impairment of certain skills such as reading or writing, coordination, self-control, or attention that interfere with the ability to learn. The impairment is not related to a global deficiency of intelligence. Evidence: IEA. (OMIM:300491)
- X-linked dominant inheritance (HP:0001423): A mode of inheritance that is observed for dominant traits related to a gene encoded on the X chromosome. In the context of medical genetics, X-linked dominant disorders tend to manifest very severely in affected males. The severity of manifestation in females may depend on the degree of skewed X inactivation. Evidence: TAS. (OMIM:300491)
- Macrocephaly (HP:0000256): Occipitofrontal (head) circumference greater than 97th centile compared to appropriate, age matched, sex-matched normal standards. Alternatively, a apparently increased size of the cranium. Evidence: IEA. Frequency: Occasional (HP:0040283). (OMIM:300491)
- Focal-onset seizure (HP:0007359): A focal-onset seizure is a type of seizure originating within networks limited to one hemisphere. They may be discretely localized or more widely distributed, and may originate in subcortical structures. Evidence: TAS. (OMIM:300491)
These phenotypes are associated with the disease epilepsy, X-linked 1, with variable learning disabilities and behavior disorders (OMIM:300491).